- Autosomal recessive inheritance (HP:0000007): A mode of inheritance that is observed for traits related to a gene encoded on one of the autosomes (i.e., the human chromosomes 1-22) in which a trait manifests in individuals with two pathogenic alleles, either homozygotes (two copies of the same mutant allele) or compound heterozygotes (whereby each copy of a gene has a distinct mutant allele). Evidence: PCS. (PMID:19956407)
- Rod-cone dystrophy (HP:0000510): An inherited retinal disease subtype in which the rod photoreceptors appear to be more severely affected than the cone photoreceptors. Typical presentation is with nyctalopia (due to rod dysfunction) followed by loss of mid-peripheral field of vision, which gradually extends and leaves many patients with a small central island of vision due to the preservation of macular cones. Evidence: PCS. (PMID:19956407)
These phenotypes are associated with the disease retinitis pigmentosa 55 (OMIM:613575).